- Male infertility (HP:0003251). Evidence: PCS. Frequency: 2/2. (PMID:19344877)
- Young adult onset (HP:0011462): Onset of disease at the age of between 16 and 40 years. Evidence: PCS. Frequency: 2/2. (PMID:19344877)
- Autosomal recessive inheritance (HP:0000007): A mode of inheritance that is observed for traits related to a gene encoded on one of the autosomes (i.e., the human chromosomes 1-22) in which a trait manifests in individuals with two pathogenic alleles, either homozygotes (two copies of the same mutant allele) or compound heterozygotes (whereby each copy of a gene has a distinct mutant allele). Evidence: PCS. (PMID:19344877)
- Reduced sperm motility (HP:0012207): An abnormal reduction in the mobility of ejaculated sperm. Evidence: PCS. Frequency: 2/2. (PMID:19344877)
- Immotile sperm (HP:0012208): A lack of mobility of ejaculated sperm. Evidence: PCS. Frequency: 1/2. (PMID:19344877)
- Oligozoospermia (HP:0000798): Reduced count of spermatozoa in the semen, defined as a sperm count below 20 million per milliliter semen. Evidence: PCS. Frequency: 2/2. (PMID:19344877)
These phenotypes are associated with the disease spermatogenic failure 7 (OMIM:612997).